Phenotypes associated with the disease incisors, rotation of upper central (OMIM:147350):
- Rotated maxillary central incisors (HP:0006330). Evidence: IEA. (OMIM:147350)
- Autosomal dominant inheritance (HP:0000006): A mode of inheritance that is observed for traits related to a gene encoded on one of the autosomes (i.e., the human chromosomes 1-22) in which a trait manifests in heterozygotes. In the context of medical genetics, an autosomal dominant disorder is caused when a single copy of the mutant allele is present. Males and females are affected equally, and can both transmit the disorder with a risk of 50% for each child of inheriting the mutant allele. Evidence: IEA. (OMIM:147350)